Phenotypes associated with the disease spermatogenic failure 10 (OMIM:614822):
- Male infertility (HP:0003251). Evidence: PCS. Frequency: 2/2. (PMID:22275165)
- Young adult onset (HP:0011462): Onset of disease at the age of between 16 and 40 years. Evidence: PCS. Frequency: 2/2. (PMID:22275165)
- Reduced sperm motility (HP:0012207): An abnormal reduction in the mobility of ejaculated sperm. Evidence: PCS. Frequency: 1/2. (PMID:22275165)
- Autosomal dominant inheritance (HP:0000006): A mode of inheritance that is observed for traits related to a gene encoded on one of the autosomes (i.e., the human chromosomes 1-22) in which a trait manifests in heterozygotes. In the context of medical genetics, an autosomal dominant disorder is caused when a single copy of the mutant allele is present. Males and females are affected equally, and can both transmit the disorder with a risk of 50% for each child of inheriting the mutant allele. Evidence: PCS. (PMID:22479503)
- Abnormal sperm morphology (HP:0012864): A structural anomaly of sperm. Evidence: PCS. Frequency: 2/2. (PMID:22275165)
- Oligozoospermia (HP:0000798): Reduced count of spermatozoa in the semen, defined as a sperm count below 20 million per milliliter semen. Evidence: PCS. Frequency: 1/2. (PMID:22275165)